Phenotypes associated with the disease immunoglobulin A deficiency 2 (OMIM:609529):
- Recurrent sinopulmonary infections (HP:0005425): An increased susceptibility to infections involving both the paranasal sinuses and the lungs, as manifested by a history of recurrent sinopulmonary infections. Evidence: IEA. (OMIM:609529)
- Recurrent infection of the gastrointestinal tract (HP:0004798): Recurrent infection of the gastrointestinal tract. Evidence: IEA. (OMIM:609529)
- Autoimmunity (HP:0002960): The occurrence of an immune reaction against the organism's own cells or tissues. Evidence: IEA. (OMIM:609529)
- Abnormal lymphocyte morphology (HP:0004332): An abnormality of lymphocytes. Evidence: IEA. (OMIM:609529)
- Decreased circulating IgA concentration (HP:0002720): Decreased levels of immunoglobulin A (IgA). Evidence: IEA. (OMIM:609529)